Phenotypes associated with the disease Hypoglossia-hypodactyly syndrome (ORPHA:989):
- Narrow mouth (HP:0000160): Distance between the commissures of the mouth more than 2 SD below the mean. Alternatively, an apparently decreased width of the oral aperture (subjective). Evidence: TAS. Frequency: Very frequent (HP:0040281). (ORPHA:989)
- Cleft palate (HP:0000175): Cleft palate is a developmental defect of the palate resulting from a failure of fusion of the palatine processes and manifesting as a separation of the roof of the mouth (soft and hard palate). Evidence: TAS. Frequency: Frequent (HP:0040282). (ORPHA:989)
- High palate (HP:0000218): Height of the palate more than 2 SD above the mean (objective) or palatal height at the level of the first permanent molar more than twice the height of the teeth (subjective). Evidence: TAS. Frequency: Occasional (HP:0040283). (ORPHA:989)
- Facial asymmetry (HP:0000324): An abnormal difference between the left and right sides of the face. Evidence: TAS. Frequency: Occasional (HP:0040283). (ORPHA:989)
- Micrognathia (HP:0000347): Developmental hypoplasia of the mandible. Evidence: TAS. Frequency: Very frequent (HP:0040281). (ORPHA:989)
- Wide nasal bridge (HP:0000431): Increased breadth of the nasal bridge (and with it, the nasal root). Evidence: TAS. Frequency: Frequent (HP:0040282). (ORPHA:989)
- Telecanthus (HP:0000506): Distance between the inner canthi more than two standard deviations above the mean (objective); or, apparently increased distance between the inner canthi. Evidence: TAS. Frequency: Frequent (HP:0040282). (ORPHA:989)
- Hypodontia (HP:0000668): The absence of five or less teeth from the normal series by a failure to develop. Evidence: TAS. Frequency: Frequent (HP:0040282). (ORPHA:989)
- Brachydactyly (HP:0001156): Digits that appear disproportionately short compared to the hand/foot. The word brachydactyly is used here to describe a series distinct patterns of shortened digits (brachydactyly types A-E). This is the sense used here. Evidence: TAS. Frequency: Frequent (HP:0040282). (ORPHA:989)
- Split hand (HP:0001171): A condition in which middle parts of the hand (fingers and metacarpals) are missing giving a cleft appearance. The severity is very variable ranging from slightly hypoplastic middle fingers over absent middle fingers as far as oligo- or monodactyl hands. Evidence: TAS. Frequency: Frequent (HP:0040282). (ORPHA:989)
- Abnormal fingernail morphology (HP:0001231): An abnormality of the fingernails. Evidence: TAS. Frequency: Frequent (HP:0040282). (ORPHA:989)
- Intellectual disability (HP:0001249): The term intellectual disability or intellectual developmental disorder is used to describe significantly sub-average intellectual and adaptive functioning based on clinical assessment and as measured by individually administered, appropriately normed, standardized and validated tests of intellectual functioning and adaptive behavior, with onset during the developmental period from infancy through adolescence. Evidence: TAS. Frequency: Occasional (HP:0040283). (ORPHA:989)
- Abnormal cranial nerve morphology (HP:0001291): Structural abnormality affecting one or more of the cranial nerves, which emerge directly from the brain stem. Evidence: TAS. Frequency: Occasional (HP:0040283). (ORPHA:989)
- Death in infancy (HP:0001522): Death within the first 24 months of life. Evidence: TAS. Frequency: Occasional (HP:0040283). (ORPHA:989)
- Gastroschisis (HP:0001543): A type of congenital ventral incomplete closure of the abdominal wall in which the intestines and sometimes other organs extend freely into the amniotic fluid space through a small opening in the abdomen, usually to the right of the umbilicus. Evidence: TAS. Frequency: Occasional (HP:0040283). (ORPHA:989)
- Anal atresia (HP:0002023): Congenital absence of the anus, i.e., the opening at the bottom end of the intestinal tract. Evidence: TAS. Frequency: Occasional (HP:0040283). (ORPHA:989)
- Abnormal speech pattern (HP:0002167): An abnormality in the sound (volume) or cadence (rate) of speech. Evidence: TAS. Frequency: Occasional (HP:0040283). (ORPHA:989)
- Jejunal atresia (HP:0005235): A developmental defect resulting in abnormal closure, or atresia of the tubular structure of the jejunum. Evidence: TAS. Frequency: Occasional (HP:0040283). (ORPHA:989)
- Finger syndactyly (HP:0006101): Webbing or fusion of the fingers, involving soft parts only or including bone structure. Bony fusions are referred to as "bony" Syndactyly if the fusion occurs in a radio-ulnar axis. Fusions of bones of the fingers in a proximo-distal axis are referred to as "Symphalangism". Evidence: TAS. Frequency: Frequent (HP:0040282). (ORPHA:989)
- Aplasia/Hypoplasia of fingers (HP:0006265): Small/hypoplastic or absent/aplastic fingers. Evidence: TAS. Frequency: Frequent (HP:0040282). (ORPHA:989)
- Feeding difficulties in infancy (HP:0008872): Impaired feeding performance of an infant as manifested by difficulties such as weak and ineffective sucking, brief bursts of sucking, and falling asleep during sucking. There may be difficulties with chewing or maintaining attention. Evidence: TAS. Frequency: Occasional (HP:0040283). (ORPHA:989)
- Adactyly (HP:0009776): The absence of all phalanges of all the digits of a limb and the associated soft tissues. Evidence: TAS. Frequency: Frequent (HP:0040282). (ORPHA:989)
- Upper limb phocomelia (HP:0009813): Missing or malformed long bones of the upper limbs with the distal parts (the hands) connected to the variably shortened or even absent upper extremity, leading to a flipper-like appearance, as opposed to other forms of limb malformations were either the whole limb is missing (such as amelia), or the distal part of a limb is absent (peromelia). Evidence: TAS. Frequency: Very frequent (HP:0040281). (ORPHA:989)
- Short distal phalanx of finger (HP:0009882): Short distance from the end of the finger to the most distal interphalangeal crease or the distal interphalangeal joint flexion point. That is, hypoplasia of one or more of the distal phalanx of finger. Evidence: TAS. Frequency: Frequent (HP:0040282). (ORPHA:989)
- Aplasia/Hypoplasia of the tongue (HP:0010295): Absence or underdevelopment of the tongue. Evidence: TAS. Frequency: Very frequent (HP:0040281). (ORPHA:989)
- Hypoplasia of the zygomatic bone (HP:0010669): Underdevelopment of the zygomatic bone. That is, a reduction in size of the zygomatic bone, including the zygomatic process of the temporal bone of the skull, which forms part of the zygomatic arch. Evidence: TAS. Frequency: Very frequent (HP:0040281). (ORPHA:989)